- Poor speech (HP:0002465). Evidence: PCS. Frequency: 2/2. (PMID:25753423)
- Delayed speech and language development (HP:0000750): A degree of language development that is significantly below the norm for a child of a specified age. Evidence: PCS. Frequency: 2/2. (PMID:25753423)
- Narrow palate (HP:0000189): Width of the palate more than 2 SD below the mean (objective) or apparently decreased palatal width (subjective). Evidence: PCS. Frequency: 1/1. (PMID:33161245)
- Wide nasal bridge (HP:0000431): Increased breadth of the nasal bridge (and with it, the nasal root). Evidence: PCS. Frequency: 1/1. (PMID:33161245)
- Long face (HP:0000276): Facial height (length) is more than 2 standard deviations above the mean (objective); or, an apparent increase in the height (length) of the face (subjective). Evidence: PCS. Frequency: 2/2. (PMID:25753423)
- Brachydactyly (HP:0001156): Digits that appear disproportionately short compared to the hand/foot. The word brachydactyly is used here to describe a series distinct patterns of shortened digits (brachydactyly types A-E). This is the sense used here. Evidence: PCS. Frequency: 1/1. (PMID:33161245)
- Seizure (HP:0001250): A seizure is an intermittent abnormality of nervous system physiology characterized by a transient occurrence of signs and/or symptoms due to abnormal excessive or synchronous neuronal activity in the brain. Evidence: PCS. Frequency: 1/1. (PMID:33161245)
- Global developmental delay (HP:0001263): A delay in the achievement of motor or mental milestones in the domains of development of a child, including motor skills, speech and language, cognitive skills, and social and emotional skills. This term should only be used to describe children younger than five years of age. Evidence: PCS. Frequency: 1/1. (PMID:33161245)
- Infantile onset (HP:0003593): Onset of signs or symptoms of disease between 28 days to one year of life. Evidence: PCS. Frequency: 2/2. (PMID:25753423)
- Relative macrocephaly (HP:0004482): A relatively mild degree of macrocephaly in which the head circumference is not above two standard deviations from the mean, but appears dysproportionately large when other factors such as body stature are taken into account. Evidence: PCS. Frequency: 2/2. (PMID:25753423)
- EEG with polyspike wave complexes (HP:0002392): The presence of complexes of repetitive spikes and waves in EEG. Evidence: PCS. Frequency: 1/1. (PMID:33161245)
- Childhood onset (HP:0011463): Onset of disease at the age of between 1 and 5 years. Evidence: PCS. Frequency: 1/1. (PMID:33161245)
- Prominent nose (HP:0000448): Distance between subnasale and pronasale more than two standard deviations above the mean, or alternatively, an apparently increased anterior protrusion of the nasal tip. Evidence: PCS. Frequency: 2/2. (PMID:25753423)
- Autosomal recessive inheritance (HP:0000007): A mode of inheritance that is observed for traits related to a gene encoded on one of the autosomes (i.e., the human chromosomes 1-22) in which a trait manifests in individuals with two pathogenic alleles, either homozygotes (two copies of the same mutant allele) or compound heterozygotes (whereby each copy of a gene has a distinct mutant allele). Evidence: PCS. (PMID:25753423)
- Hyperactivity (HP:0000752): Hyperactivity is a condition characterized by constant and unusually high levels of activity, even in situations where it is deemed inappropriate. Evidence: PCS. Frequency: 2/2. (PMID:25753423)
- Dolichocephaly (HP:0000268): An abnormality of skull shape characterized by a increased anterior-posterior diameter, i.e., an increased antero-posterior dimension of the skull. Cephalic index less than 76%. Alternatively, an apparently increased antero-posterior length of the head compared to width. Often due to premature closure of the sagittal suture. Evidence: PCS. Frequency: 1/1. (PMID:33161245)
- Macrocephaly (HP:0000256): Occipitofrontal (head) circumference greater than 97th centile compared to appropriate, age matched, sex-matched normal standards. Alternatively, a apparently increased size of the cranium. Evidence: PCS. Frequency: 1/1. (PMID:33161245)
- Mandibular prognathia (HP:0000303): Abnormal prominence of the chin related to increased length of the mandible. Evidence: PCS. Frequency: 2/2. (PMID:25753423)
- Intellectual disability (HP:0001249): The term intellectual disability or intellectual developmental disorder is used to describe significantly sub-average intellectual and adaptive functioning based on clinical assessment and as measured by individually administered, appropriately normed, standardized and validated tests of intellectual functioning and adaptive behavior, with onset during the developmental period from infancy through adolescence. Evidence: PCS. Frequency: 3/3. (PMID:25753423;PMID:33161245)
These phenotypes are associated with the disease intellectual developmental disorder, autosomal recessive 74 (OMIM:617169).